- Abnormality of the pharynx (HP:0000600): An anomaly of the pharynx, i.e., of the tubular structure extending from the base of the skull superiorly to the esophageal inlet inferiorly. Evidence: TAS. Frequency: Occasional (HP:0040283). (ORPHA:2289)
- Ophthalmoplegia (HP:0000602): Paralysis of one or more extraocular muscles that are responsible for eye movements. Evidence: TAS. Frequency: Frequent (HP:0040282). (ORPHA:2289)
- Nystagmus (HP:0000639): Rhythmic, involuntary oscillations of one or both eyes related to abnormality in fixation, conjugate gaze, or vestibular mechanisms. Evidence: TAS. Frequency: Frequent (HP:0040282). (ORPHA:2289)
- Optic atrophy (HP:0000648): Atrophy of the optic nerve. Optic atrophy results from the death of the retinal ganglion cell axons that comprise the optic nerve and manifesting as a pale optic nerve on fundoscopy. Evidence: TAS. Frequency: Occasional (HP:0040283). (ORPHA:2289)
- Atypical behavior (HP:0000708): Atypical behavior is an abnormality in a person's actions that can be controlled or modulated by the will of the individual. While abnormal behaviors can be difficult to control, they are distinct from other abnormal actions that cannot be affected by the individual's will. Evidence: TAS. Frequency: Frequent (HP:0040282). (ORPHA:2289)
- Dementia (HP:0000726): A loss of global cognitive ability of sufficient amount to interfere with normal social or occupational function. Dementia represents a loss of previously present cognitive abilities, generally in adults, and can affect memory, thinking, language, judgment, and behavior. Evidence: TAS. Frequency: Frequent (HP:0040282). (ORPHA:2289)
- Seizure (HP:0001250): A seizure is an intermittent abnormality of nervous system physiology characterized by a transient occurrence of signs and/or symptoms due to abnormal excessive or synchronous neuronal activity in the brain. Evidence: TAS. Frequency: Frequent (HP:0040282). (ORPHA:2289)
- Ataxia (HP:0001251): Ataxia refers to impaired coordination of voluntary muscle movement. Cerebellar ataxia refers to ataxia due to dysfunction of the cerebellum. This causes a variety of elementary neurological deficits including asynergy (lack of coordination between muscles, limbs and joints), dysmetria (lack of ability to judge distances that can lead to under- or overshoot in grasping movements), and dysdiadochokinesia (inability to perform rapid movements requiring antagonizing muscle groups to be switched on and off repeatedly). Evidence: TAS. Frequency: Very frequent (HP:0040281). (ORPHA:2289)
- Dysarthria (HP:0001260): Dysarthric speech is a general description referring to a neurological speech disorder characterized by poor articulation. Depending on the involved neurological structures, dysarthria may be further classified as spastic, flaccid, ataxic, hyperkinetic and hypokinetic, or mixed. Evidence: TAS. Frequency: Very frequent (HP:0040281). (ORPHA:2289)
- Hypertonia (HP:0001276): A condition in which there is increased muscle tone so that arms or legs, for example, are stiff and difficult to move. Evidence: TAS. Frequency: Frequent (HP:0040282). (ORPHA:2289)
- Hyperreflexia (HP:0001347): Hyperreflexia is the presence of hyperactive stretch reflexes of the muscles. Evidence: TAS. Frequency: Frequent (HP:0040282). (ORPHA:2289)
- Abnormal speech pattern (HP:0002167): An abnormality in the sound (volume) or cadence (rate) of speech. Evidence: TAS. Frequency: Very frequent (HP:0040281). (ORPHA:2289)
- EEG abnormality (HP:0002353): Abnormality observed by electroencephalogram (EEG), which is used to record of the brain's spontaneous electrical activity from multiple electrodes placed on the scalp. Evidence: TAS. Frequency: Frequent (HP:0040282). (ORPHA:2289)
- Scoliosis (HP:0002650): The presence of an abnormal lateral curvature of the spine. Evidence: TAS. Frequency: Frequent (HP:0040282). (ORPHA:2289)
- Spina bifida occulta (HP:0003298): The closed form of spina bifida with incomplete closure of a vertebral body with intact overlying skin. Evidence: TAS. Frequency: Frequent (HP:0040282). (ORPHA:2289)
- Abnormal vertebral body morphology (HP:0003312): Abnormal form of vertebral body, which is the central cylindrical portion of the vertebra that together with other structures such as the vertebral arch, pedicles, laminae, spinous process, transverse processes, and articular facets makes up a vertebra. Evidence: TAS. Frequency: Frequent (HP:0040282). (ORPHA:2289)
- EMG abnormality (HP:0003457): Abnormal results of investigations using electromyography (EMG). Evidence: TAS. Frequency: Very frequent (HP:0040281). (ORPHA:2289)
- Abnormality of movement (HP:0100022): An abnormality of movement with a neurological basis characterized by changes in coordination and speed of voluntary movements. Evidence: TAS. Frequency: Very frequent (HP:0040281). (ORPHA:2289)
These phenotypes are associated with the disease Neuronal intranuclear inclusion disease (ORPHA:2289).